- X-linked recessive inheritance (HP:0001419): A mode of inheritance that is observed for recessive traits related to a gene encoded on the X chromosome. In the context of medical genetics, X-linked recessive disorders manifest in males (who have one copy of the X chromosome and are thus hemizygotes), but generally not in female heterozygotes who have one mutant and one normal allele. Evidence: TAS. (OMIM:300030)
- Congenital sensorineural hearing impairment (HP:0008527): A type of hearing impairment caused by an abnormal functionality of the cochlear nerve with congenital onset. Evidence: TAS. (OMIM:300030)
These phenotypes are associated with the disease hearing loss, X-linked 3 (OMIM:300030).